- Childhood onset (HP:0011463): Onset of disease at the age of between 1 and 5 years. Evidence: PCS. (PMID:8696335)
- Hypodontia (HP:0000668): The absence of five or less teeth from the normal series by a failure to develop. Evidence: PCS. (PMID:8696335)
- Autosomal dominant inheritance (HP:0000006): A mode of inheritance that is observed for traits related to a gene encoded on one of the autosomes (i.e., the human chromosomes 1-22) in which a trait manifests in heterozygotes. In the context of medical genetics, an autosomal dominant disorder is caused when a single copy of the mutant allele is present. Males and females are affected equally, and can both transmit the disorder with a risk of 50% for each child of inheriting the mutant allele. Evidence: PCS. (PMID:8696335)
These phenotypes are associated with the disease tooth agenesis, selective, 1 (OMIM:106600).